- Abnormal vertebral morphology (HP:0003468): An abnormality of one or more of the vertebrae. Evidence: TAS. Frequency: Very frequent (HP:0040281). (ORPHA:99688)
- Proportionate short stature (HP:0003508): A kind of short stature in which different regions of the body are shortened to a comparable extent. Evidence: TAS. Frequency: Very frequent (HP:0040281). (ORPHA:99688)
- Depressed nasal bridge (HP:0005280): Posterior positioning of the nasal root in relation to the overall facial profile for age. Evidence: TAS. Frequency: Very frequent (HP:0040281). (ORPHA:99688)
- Ichthyosis (HP:0008064): An abnormality of the skin characterized the presence of excessive amounts of dry surface scales on the skin resulting from an abnormality of keratinization. Evidence: TAS. Frequency: Very frequent (HP:0040281). (ORPHA:99688)
- Nail dystrophy (HP:0008404): Onychodystrophy (nail dystrophy) refers to nail changes apart from changes of the color (nail dyschromia) and involves partial or complete disruption of the various keratinous layers of the nail plate. Evidence: TAS. Frequency: Very frequent (HP:0040281). (ORPHA:99688)
- Hyperconvex toenail (HP:0030055): When viewed on end (with the tip of the toe pointing toward the examiner's eye) the curve of the toenail forms a tighter curve of convexity. Evidence: TAS. Frequency: Very frequent (HP:0040281). (ORPHA:99688)
- Anemia (HP:0001903): A reduction in erythrocytes volume or hemoglobin concentration. Evidence: TAS. Frequency: Occasional (HP:0040283). (ORPHA:99688)
- Aminoaciduria (HP:0003355): An increased concentration of an amino acid in the urine. Evidence: TAS. Frequency: Occasional (HP:0040283). (ORPHA:99688)
- Short nose (HP:0003196): Distance from nasion to subnasale more than two standard deviations below the mean, or alternatively, an apparently decreased length from the nasal root to the nasal tip. Evidence: TAS. Frequency: Very frequent (HP:0040281). (ORPHA:99688)
- Macrotia (HP:0000400): Median longitudinal ear length greater than two standard deviations above the mean and median ear width greater than two standard deviations above the mean (objective); or, apparent increase in length and width of the pinna (subjective). Evidence: TAS. Frequency: Very frequent (HP:0040281). (ORPHA:99688)
- Blepharophimosis (HP:0000581): A fixed reduction in the vertical distance between the upper and lower eyelids with short palpebral fissures. Evidence: TAS. Frequency: Very frequent (HP:0040281). (ORPHA:99688)
- Hypohidrosis (HP:0000966): Abnormally diminished capacity to sweat. Evidence: TAS. Frequency: Very frequent (HP:0040281). (ORPHA:99688)
- Intellectual disability (HP:0001249): The term intellectual disability or intellectual developmental disorder is used to describe significantly sub-average intellectual and adaptive functioning based on clinical assessment and as measured by individually administered, appropriately normed, standardized and validated tests of intellectual functioning and adaptive behavior, with onset during the developmental period from infancy through adolescence. Evidence: TAS. Frequency: Very frequent (HP:0040281). (ORPHA:99688)
- Seizure (HP:0001250): A seizure is an intermittent abnormality of nervous system physiology characterized by a transient occurrence of signs and/or symptoms due to abnormal excessive or synchronous neuronal activity in the brain. Evidence: TAS. Frequency: Very frequent (HP:0040281). (ORPHA:99688)
- Frontal bossing (HP:0002007): Bilateral bulging of the lateral frontal bone prominences with relative sparing of the midline. Evidence: TAS. Frequency: Very frequent (HP:0040281). (ORPHA:99688)
- Aganglionic megacolon (HP:0002251): An abnormality resulting from a lack of intestinal ganglion cells (i.e., an aganglionic section of bowel) that results in bowel obstruction with enlargement of the colon. Evidence: TAS. Frequency: Very frequent (HP:0040281). (ORPHA:99688)
- EEG abnormality (HP:0002353): Abnormality observed by electroencephalogram (EEG), which is used to record of the brain's spontaneous electrical activity from multiple electrodes placed on the scalp. Evidence: TAS. Frequency: Very frequent (HP:0040281). (ORPHA:99688)
These phenotypes are associated with the disease Dermotrichic syndrome (ORPHA:99688).